Phenotypes associated with the disease retinitis pigmentosa 38 (OMIM:613862):
- Constriction of peripheral visual field (HP:0001133): An absolute or relative decrease in retinal sensitivity extending from edge (periphery) of the visual field in a concentric pattern. The visual field is the area that is perceived simultaneously by a fixating eye. Evidence: PCS. Frequency: 2/2. (PMID:11062461)
- Nyctalopia (HP:0000662): Inability to see well at night or in poor light. Evidence: PCS. Frequency: 2/2. (PMID:11062461)
- Peripheral retinal atrophy (HP:0200070): A nonspecific term denoting wasting, especially as a result of degeneration, of the peripheral retinal pigment epithelium (RPE) and neurosensory retinal cells. Evidence: TAS. (OMIM:613862)
- Progressive visual loss (HP:0000529): A reduction of previously attained ability to see. Evidence: PCS. Frequency: 2/2. (PMID:11062461)
- Childhood onset (HP:0011463): Onset of disease at the age of between 1 and 5 years. Evidence: PCS. Frequency: 2/2. (PMID:11062461)
- Autosomal recessive inheritance (HP:0000007): A mode of inheritance that is observed for traits related to a gene encoded on one of the autosomes (i.e., the human chromosomes 1-22) in which a trait manifests in individuals with two pathogenic alleles, either homozygotes (two copies of the same mutant allele) or compound heterozygotes (whereby each copy of a gene has a distinct mutant allele). Evidence: PCS. (PMID:11062461)
- Macular atrophy (HP:0007401): A nonspecific term denoting wasting, especially as a result of degeneration, of the retinal pigment epithelium (RPE) and neurosensory retinal cells in the macula. Evidence: TAS. (OMIM:613862)
- Optic disc pallor (HP:0000543): A pale yellow discoloration of the optic disc (the area of the optic nerve head in the retina). The optic disc normally has a pinkish hue with a central yellowish depression. Evidence: TAS. (OMIM:613862)
- Rod-cone dystrophy (HP:0000510): An inherited retinal disease subtype in which the rod photoreceptors appear to be more severely affected than the cone photoreceptors. Typical presentation is with nyctalopia (due to rod dysfunction) followed by loss of mid-peripheral field of vision, which gradually extends and leaves many patients with a small central island of vision due to the preservation of macular cones. Evidence: PCS. Frequency: 2/2. (PMID:11062461)